Phenotypes associated with the disease C syndrome (OMIM:211750):
- Epicanthus (HP:0000286): A fold of skin starting above the medial aspect of the upper eyelid and arching downward to cover, pass in front of and lateral to the medial canthus. Evidence: IEA. (OMIM:211750)
- Upslanted palpebral fissure (HP:0000582): The palpebral fissure inclination is more than two standard deviations above the mean for age (objective); or, the inclination of the palpebral fissure is greater than typical for age. Evidence: IEA. (OMIM:211750)
- Toe syndactyly (HP:0001770): Webbing or fusion of the toes, involving soft parts only or including bone structure. Bony fusions are referred to as "bony" Syndactyly if the fusion occurs in a radio-ulnar axis. Fusions of bones of the toes in a proximo-distal axis are referred to as "Symphalangism". Evidence: IEA. (OMIM:211750)
- Micromelia (HP:0002983): The presence of abnormally small extremities. Evidence: TAS. (OMIM:211750)
- Strabismus (HP:0000486): A misalignment of the eyes so that the visual axes deviate from bifoveal fixation. The classification of strabismus may be based on a number of features including the relative position of the eyes, whether the deviation is latent or manifest, intermittent or constant, concomitant or otherwise and according to the age of onset and the relevance of any associated refractive error. Evidence: IEA. (OMIM:211750)
- Trigonocephaly (HP:0000243): Wedge-shaped, or triangular head, with the apex of the triangle at the midline of the forehead and the base of the triangle at the occiput. Evidence: IEA. (OMIM:211750)
- Anteverted nares (HP:0000463): Anteriorly-facing nostrils viewed with the head in the Frankfurt horizontal and the eyes of the observer level with the eyes of the subject. This gives the appearance of an upturned nose (upturned nasal tip). Evidence: IEA. (OMIM:211750)
- Short stature (HP:0004322): A height below that which is expected according to age and gender norms. Although there is no universally accepted definition of short stature, many refer to "short stature" as height more than 2 standard deviations below the mean for age and gender (or below the 3rd percentile for age and gender dependent norms). Evidence: IEA. (OMIM:211750)
- Seizure (HP:0001250): A seizure is an intermittent abnormality of nervous system physiology characterized by a transient occurrence of signs and/or symptoms due to abnormal excessive or synchronous neuronal activity in the brain. Evidence: IEA. (OMIM:211750)
- Hypotonia (HP:0001252): Hypotonia is an abnormally low muscle tone (the amount of tension or resistance to movement in a muscle). Even when relaxed, muscles have a continuous and passive partial contraction which provides some resistance to passive stretching. Hypotonia thus manifests as diminished resistance to passive stretching. Hypotonia is not the same as muscle weakness, although the two conditions can co-exist. Evidence: IEA. (OMIM:211750)
- Short nose (HP:0003196): Distance from nasion to subnasale more than two standard deviations below the mean, or alternatively, an apparently decreased length from the nasal root to the nasal tip. Evidence: IEA. (OMIM:211750)
- Hepatomegaly (HP:0002240): Abnormally increased size of the liver. Evidence: IEA. (OMIM:211750)
- Short metacarpal (HP:0010049): Diminished length of one or more metacarpal bones in relation to the others of the same hand or to the contralateral metacarpal. Evidence: IEA. (OMIM:211750)
- Generalized hypotonia (HP:0001290): Generalized muscular hypotonia (abnormally low muscle tone). Evidence: TAS. (OMIM:211750)
- Failure to thrive (HP:0001508): Failure to thrive (FTT) refers to a child whose physical growth is substantially below the norm. Evidence: IEA. (OMIM:211750)
- Ventricular septal defect (HP:0001629): A hole between the two bottom chambers (ventricles) of the heart. The defect is centered around the most superior aspect of the ventricular septum. Evidence: IEA. (OMIM:211750)
- Thick anterior alveolar ridges (HP:0009100). Evidence: IEA. (OMIM:211750)
- Ulnar deviation of finger (HP:0009465): Bending or curvature of a finger toward the ulnar side (i.e., away from the thumb). The deviation is at the metacarpal-phalangeal joint, and this finding is distinct from clinodactyly. Evidence: IEA. (OMIM:211750)
- Radial deviation of finger (HP:0009466): Bending or curvature of a finger toward the radial side (i.e., towards the thumb). The deviation is at the metacarpal-phalangeal joint, and this finding is distinct from clinodactyly. Evidence: IEA. (OMIM:211750)
- High palate (HP:0000218): Height of the palate more than 2 SD above the mean (objective) or palatal height at the level of the first permanent molar more than twice the height of the teeth (subjective). Evidence: IEA. (OMIM:211750)
- Clinodactyly (HP:0030084): An angulation of a digit at an interphalangeal joint in the plane of the palm (finger) or sole (toe). Evidence: TAS. (OMIM:211750)
- Patent ductus arteriosus (HP:0001643): In utero, the ductus arteriosus (DA) serves to divert ventricular output away from the lungs and toward the placenta by connecting the main pulmonary artery to the descending aorta. A patent ductus arteriosus (PDA) in the first 3 days of life is a physiologic shunt in healthy term and preterm newborn infants, and normally is substantially closed within about 24 hours after bith and completely closed after about three weeks. Failure of physiologcal closure is referred to a persistent or patent ductus arteriosus (PDA). Depending on the degree of left-to-right shunting, PDA can have clinical consequences. Evidence: IEA. (OMIM:211750)
- Posteriorly rotated ears (HP:0000358): A type of abnormal location of the ears in which the position of the ears is characterized by posterior rotation (the superior part of the ears is rotated towards the back of the head, and the inferior part of the ears towards the front). Evidence: IEA. (OMIM:211750)
- Cutis laxa (HP:0000973): Wrinkled, redundant, inelastic and sagging skin. Evidence: IEA. (OMIM:211750)
- Wide mouth (HP:0000154): Distance between the oral commissures more than 2 SD above the mean. Alternatively, an apparently increased width of the oral aperture (subjective). Evidence: IEA. (OMIM:211750)
- Microcephaly (HP:0000252): Head circumference below 2 standard deviations below the mean for age and gender. Evidence: IEA. (OMIM:211750)
- Limb undergrowth (HP:0009826): Limb shortening because of underdevelopment of one or more bones of the extremities. Evidence: IEA. (OMIM:211750)
- Wide nasal bridge (HP:0000431): Increased breadth of the nasal bridge (and with it, the nasal root). Evidence: IEA. (OMIM:211750)
- Scoliosis (HP:0002650): The presence of an abnormal lateral curvature of the spine. Evidence: IEA. (OMIM:211750)
- Delayed skeletal maturation (HP:0002750): A decreased rate of skeletal maturation. Delayed skeletal maturation can be diagnosed on the basis of an estimation of the bone age from radiographs of specific bones in the human body. Evidence: IEA. (OMIM:211750)
- Postaxial hand polydactyly (HP:0001162): Supernumerary digits located at the ulnar side of the hand (that is, on the side with the fifth finger). Evidence: IEA. (OMIM:211750)
- Global developmental delay (HP:0001263): A delay in the achievement of motor or mental milestones in the domains of development of a child, including motor skills, speech and language, cognitive skills, and social and emotional skills. This term should only be used to describe children younger than five years of age. Evidence: IEA. Frequency: 20/20. (OMIM:211750)
- Accessory oral frenulum (HP:0000191): Extra fold of tissue extending from the alveolar ridge to the inner surface of the upper or lower lip. Evidence: IEA. (OMIM:211750)
- Dislocated radial head (HP:0003083): A dislocation of the head of the radius from its socket in the elbow joint. Evidence: IEA. (OMIM:211750)
- Renal cortical cysts (HP:0000803): Cysts of the cortex of the kidney. Evidence: IEA. (OMIM:211750)
- Hip dislocation (HP:0002827): Displacement of the femur from its normal location in the hip joint. Evidence: IEA. (OMIM:211750)
- Omphalocele (HP:0001539): A midline anterior incomplete closure of the abdominal wall in which there is herniation of the abdominal viscera into the base of the abdominal cord. Evidence: IEA. (OMIM:211750)
- Clitoral hypertrophy (HP:0008665): Hypertrophy of the clitoris. Evidence: IEA. (OMIM:211750)
- Postaxial foot polydactyly (HP:0001830): Polydactyly of the foot most commonly refers to the presence of six toes on one foot. Postaxial polydactyly affects the lateral ray and the duplication may range from a well-formed articulated digit to a rudimentary digit. Evidence: IEA. (OMIM:211750)
- Fused sternal ossification centers (HP:0006643). Evidence: IEA. (OMIM:211750)
- Cryptorchidism (HP:0000028): Testis in inguinal canal. That is, absence of one or both testes from the scrotum owing to failure of the testis or testes to descend through the inguinal canal to the scrotum. Evidence: IEA. (OMIM:211750)
- Micrognathia (HP:0000347): Developmental hypoplasia of the mandible. Evidence: IEA. (OMIM:211750)
- Low-set ears (HP:0000369): Upper insertion of the ear to the scalp below an imaginary horizontal line drawn between the inner canthi of the eye and extending posteriorly to the ear. Evidence: IEA. (OMIM:211750)
- Autosomal dominant inheritance (HP:0000006): A mode of inheritance that is observed for traits related to a gene encoded on one of the autosomes (i.e., the human chromosomes 1-22) in which a trait manifests in heterozygotes. In the context of medical genetics, an autosomal dominant disorder is caused when a single copy of the mutant allele is present. Males and females are affected equally, and can both transmit the disorder with a risk of 50% for each child of inheriting the mutant allele. Evidence: IEA. (OMIM:211750)